- Increased dermatoglyphic whorls (HP:0005875). Evidence: IEA. (OMIM:212100)
- Hearing impairment (HP:0000365): A decreased magnitude of the sensory perception of sound. Evidence: IEA. (OMIM:212100)
- Autosomal recessive inheritance (HP:0000007): A mode of inheritance that is observed for traits related to a gene encoded on one of the autosomes (i.e., the human chromosomes 1-22) in which a trait manifests in individuals with two pathogenic alleles, either homozygotes (two copies of the same mutant allele) or compound heterozygotes (whereby each copy of a gene has a distinct mutant allele). Evidence: IEA. (OMIM:212100)
- Ventricular hypertrophy (HP:0001714): Enlargement of the cardiac ventricular muscle tissue with increase in the width of the wall of the ventricle and loss of elasticity. Ventricular hypertrophy is clinically differentiated into left and right ventricular hypertrophy. Evidence: IEA. (OMIM:212100)
These phenotypes are associated with the disease cardioauditory syndrome of Sanchez Cascos (OMIM:212100).